- Astigmatism (HP:0000483): A type of refraction error associated with abnormal curvatures on the anterior and/or posterior surface of the cornea. Evidence: PCS. Frequency: 2/12. (PMID:35979925)
- Hypsarrhythmia (HP:0002521): Hypsarrhythmia is abnormal interictal high amplitude waves and a background of irregular spikes. There is continuous (during wakefulness), high-amplitude (>200 Hz), generalized polymorphic slowing with no organized background and multifocal spikes demonstrated by electroencephalography (EEG). Evidence: PCS. Frequency: 1/12. (PMID:35979925)
- Congenital onset (HP:0003577): A phenotypic abnormality that is present at birth. Evidence: PCS. Frequency: 1/12. (PMID:35979925)
- Strabismus (HP:0000486): A misalignment of the eyes so that the visual axes deviate from bifoveal fixation. The classification of strabismus may be based on a number of features including the relative position of the eyes, whether the deviation is latent or manifest, intermittent or constant, concomitant or otherwise and according to the age of onset and the relevance of any associated refractive error. Evidence: PCS. Frequency: 3/12. (PMID:35979925)
- Prominent fingertip pads (HP:0001212): A soft tissue prominence of the ventral aspects of the fingertips. The term "persistent fetal fingertip pads" is often used as a synonym, but should better not be used because it implies knowledge of history of the patient which often does not exist. Evidence: PCS. Frequency: 2/12. (PMID:35979925)
- Hearing impairment (HP:0000365): A decreased magnitude of the sensory perception of sound. Evidence: PCS. Frequency: 3/12. (PMID:35979925)
- Hypermetropia (HP:0000540): An abnormality of refraction characterized by the ability to see objects in the distance clearly, while objects nearby appear blurry. Evidence: PCS. Frequency: 1/12. (PMID:35979925)
- Single umbilical artery (HP:0001195): Single umbilical artery (SUA) is the absence of one of the two umbilical arteries surrounding the fetal bladder and in the fetal umbilical cord. Evidence: PCS. Frequency: 1/12. (PMID:35979925)
- Generalized non-motor (absence) seizure (HP:0002121): A generalized non-motor (absence) seizure is a type of a type of dialeptic seizure that is of electrographically generalized onset. It is a generalized seizure characterized by an interruption of activities, a blank stare, and usually the person will be unresponsive when spoken to. Any ictal motor phenomena are minor in comparison to these non-motor features. Evidence: PCS. Frequency: 2/12. (PMID:35979925)
- Infantile onset (HP:0003593): Onset of signs or symptoms of disease between 28 days to one year of life. Evidence: PCS. Frequency: 2/12. (PMID:35979925)
- Infantile spasms (HP:0012469): Infantile spasms represent a subset of "epileptic spasms". Infantile Spasms are epileptic spasms starting in the first year of life (infancy). Evidence: PCS. Frequency: 1/12. (PMID:35979925)
- Cafe-au-lait spot (HP:0000957): Cafe-au-lait spots are hyperpigmented lesions that can vary in color from light brown to dark brown with smooth borders and having a size of 1.5 cm or more in adults and 0.5 cm or more in children. Evidence: PCS. Frequency: 2/12. (PMID:35979925)
- Cleft earlobe (HP:0011265): Discontinuity in the convexity of the inferior margin of the lobe. Evidence: PCS. Frequency: 1/12. (PMID:35979925)
- Childhood onset (HP:0011463): Onset of disease at the age of between 1 and 5 years. Evidence: PCS. Frequency: 9/12. (PMID:35979925)
- Aggressive behavior (HP:0000718): Behavior or an act aimed at harming a person, animal, or physical property (e.g., acts of physical violence; shouting, swearing, and using harsh language; slashing someone's tires). Evidence: PCS. Frequency: 1/12. (PMID:35979925)
- Anxiety (HP:0000739): Intense feelings of nervousness, tension, or panic often arise in response to interpersonal stresses. There is worry about the negative effects of past unpleasant experiences and future negative possibilities. Individuals may feel fearful, apprehensive, or threatened by uncertainty, and they may also have fears of falling apart or losing control. Evidence: PCS. Frequency: 1/12. (PMID:35979925)
- Hypertelorism (HP:0000316): Interpupillary distance more than 2 SD above the mean (alternatively, the appearance of an increased interpupillary distance or widely spaced eyes). Evidence: PCS. Frequency: 1/12. (PMID:35979925)
- Thin upper lip vermilion (HP:0000219): Height of the vermilion of the upper lip in the midline more than 2 SD below the mean. Alternatively, an apparently reduced height of the vermilion of the upper lip in the frontal view (subjective). Evidence: PCS. Frequency: 2/12. (PMID:35979925)
- Low hanging columella (HP:0009765): Columella extending inferior to the level of the nasal base, when viewed from the side. Evidence: PCS. Frequency: 1/12. (PMID:35979925)
- Broad nasal tip (HP:0000455): Increase in width of the nasal tip. Evidence: PCS. Frequency: 1/12. (PMID:35979925)
- Delayed speech and language development (HP:0000750): A degree of language development that is significantly below the norm for a child of a specified age. Evidence: PCS. Frequency: 12/12. (PMID:35979925)
- Obstructive sleep apnea (HP:0002870): Obstructive Sleep Apnea is a condition characterized by the obstruction of the airway and pauses in breathing during sleep, which occur multiple times throughout the night. It is related to the relaxation of muscle tone that typically happens during sleep, leading to a partial collapse of the soft tissues in the airway and causing airflow obstruction. Evidence: PCS. Frequency: 2/12. (PMID:35979925)
- Long face (HP:0000276): Facial height (length) is more than 2 standard deviations above the mean (objective); or, an apparent increase in the height (length) of the face (subjective). Evidence: PCS. Frequency: 2/12. (PMID:35979925)
- Deeply set eye (HP:0000490): An eye that is more deeply recessed into the plane of the face than is typical. Evidence: PCS. Frequency: 1/12. (PMID:35979925)
- Global developmental delay (HP:0001263): A delay in the achievement of motor or mental milestones in the domains of development of a child, including motor skills, speech and language, cognitive skills, and social and emotional skills. This term should only be used to describe children younger than five years of age. Evidence: PCS. Frequency: 5/12. (PMID:35979925)
- Low anterior hairline (HP:0000294): Distance between the hairline (trichion) and the glabella (the most prominent point on the frontal bone above the root of the nose), in the midline, more than two SD below the mean. Alternatively, an apparently decreased distance between the hairline and the glabella. Evidence: PCS. Frequency: 1/12. (PMID:35979925)
- Autistic behavior (HP:0000729): Persistent deficits in social interaction and communication and interaction as well as a markedly restricted repertoire of activity and interest as well as repetitive patterns of behavior. Evidence: PCS. Frequency: 9/12. (PMID:35979925)
- Ptosis (HP:0000508): The upper eyelid margin is positioned 3 mm or more lower than usual and covers the superior portion of the iris (objective); or, the upper lid margin obscures at least part of the pupil (subjective). Evidence: PCS. Frequency: 1/12. (PMID:35979925)
- Umbilical hernia (HP:0001537): Protrusion of abdominal contents through a defect in the abdominal wall musculature around the umbilicus. Skin and subcutaneous tissue overlie the defect. Evidence: PCS. Frequency: 1/12. (PMID:35979925)
- Hypotelorism (HP:0000601): Interpupillary distance less than 2 SD below the mean (alternatively, the appearance of an decreased interpupillary distance or closely spaced eyes). Evidence: PCS. Frequency: 1/12. (PMID:35979925)
- Clinodactyly of the 5th finger (HP:0004209): Clinodactyly refers to a bending or curvature of the fifth finger in the radial direction (i.e., towards the 4th finger). Evidence: PCS. Frequency: 1/12. (PMID:35979925)
- Attention deficit hyperactivity disorder (HP:0007018): Attention deficit hyperactivity disorder (ADHD) manifests at age 2-3 years or by first grade at the latest. The main symptoms are distractibility, impulsivity, hyperactivity, and often trouble organizing tasks and projects, difficulty going to sleep, and social problems from being aggressive, loud, or impatient. Evidence: PCS. Frequency: 9/11. (PMID:35979925)
- Focal-onset seizure (HP:0007359): A focal-onset seizure is a type of seizure originating within networks limited to one hemisphere. They may be discretely localized or more widely distributed, and may originate in subcortical structures. Evidence: PCS. Frequency: 1/12. (PMID:35979925)
- Pierre-Robin sequence (HP:0000201): Pierre Robin malformation is a sequence of developmental malformations characterized by micrognathia (mandibular hypoplasia), glossoptosis and cleft palate. Evidence: PCS. Frequency: 1/12. (PMID:35979925)
- Sacral dimple (HP:0000960): A cutaneous indentation resulting from tethering of the skin to underlying structures (bone) of the intergluteal cleft. Evidence: PCS. Frequency: 1/12. (PMID:35979925)
- Micrognathia (HP:0000347): Developmental hypoplasia of the mandible. Evidence: PCS. Frequency: 1/12. (PMID:35979925)
- Myopia (HP:0000545): An abnormality of refraction characterized by the ability to see objects nearby clearly, while objects in the distance appear blurry. Evidence: PCS. Frequency: 1/12. (PMID:35979925)
- Autosomal dominant inheritance (HP:0000006): A mode of inheritance that is observed for traits related to a gene encoded on one of the autosomes (i.e., the human chromosomes 1-22) in which a trait manifests in heterozygotes. In the context of medical genetics, an autosomal dominant disorder is caused when a single copy of the mutant allele is present. Males and females are affected equally, and can both transmit the disorder with a risk of 50% for each child of inheriting the mutant allele. Evidence: PCS. (PMID:35979925)
These phenotypes are associated with the disease neurodevelopmental disorder with language impairment, autism, and attention deficit-hyperactivity disorder (OMIM:620782).